Phenotypes associated with the disease Idiopathic uveal effusion syndrome (ORPHA:209956):
- Abnormal sclera morphology (HP:0000591): An abnormality of the sclera. Evidence: TAS. Frequency: Very frequent (HP:0040281). (ORPHA:209956)
- Increased CSF protein concentration (HP:0002922): Increased concentration of protein in the cerebrospinal fluid. Evidence: TAS. Frequency: Frequent (HP:0040282). (ORPHA:209956)
- Abnormal anterior eye segment morphology (HP:0004328): An abnormality of the anterior segment of the eyeball (which comprises the structures in front of the vitreous humor: the cornea, iris, ciliary body, and lens). Evidence: TAS. Frequency: Frequent (HP:0040282). (ORPHA:209956)
- Reduced visual acuity (HP:0007663). Evidence: TAS. Frequency: Frequent (HP:0040282). (ORPHA:209956)
- Serous retinal detachment (HP:0012231): A type of retinal detachment such that fluid is present in the subretinal space and separate the neurosensory retina from the retinal pigment epithelium. It is not associated with a full-thickness break nor a tractional component. Due to breakdown of outer blood-retina barrier or increased exudation from abnormal vasculature or defective outflow. Evidence: TAS. Frequency: Frequent (HP:0040282). (ORPHA:209956)
- Superficial episcleral hyperemia (HP:0025339): Prominence of blood vessels of the superficial episcleral tissues. Evidence: TAS. Frequency: Frequent (HP:0040282). (ORPHA:209956)
- Scleral thickening (HP:0030823): Increased dimension of the sclera in the anterior-posterior axis. Evidence: TAS. Frequency: Frequent (HP:0040282). (ORPHA:209956)
- Subretinal fluid (HP:0031526): Fluid accumulating between the neuroretina and retinal pigment epithelium. Evidence: TAS. Frequency: Frequent (HP:0040282). (ORPHA:209956)
- Microphthalmia (HP:0000568): A developmental anomaly characterized by abnormal smallness of one or both eyes. Evidence: TAS. Frequency: Occasional (HP:0040283). (ORPHA:209956)
- Blurred vision (HP:0000622): Lack of sharpness of vision resulting in the inability to see fine detail. Evidence: TAS. Frequency: Occasional (HP:0040283). (ORPHA:209956)
- Visual field defect (HP:0001123). Evidence: TAS. Frequency: Occasional (HP:0040283). (ORPHA:209956)
- Retinal fold (HP:0008052): A wrinkle of retinal tissue projecting outward from the surface of the retina and visible as a line on fundoscopy. Evidence: TAS. Frequency: Occasional (HP:0040283). (ORPHA:209956)
- Metamorphopsia (HP:0012508): A visual anomaly in which images appear distorted. A grid of straight lines appears wavy and parts of the grid may appear blank. Evidence: TAS. Frequency: Occasional (HP:0040283). (ORPHA:209956)
Not associated with this disease:
- Abnormal intraocular pressure (HP:0012632): An anomaly in the amount of force per unit area exerted by the intraocular fluid within the eye. Evidence: TAS. (ORPHA:209956)